Phenotypes associated with the disease small cell lung carcinoma (OMIM:182280):
- Small cell lung carcinoma (HP:0030357): Small cell lung cancer (SCLC) is a type of highly malignant lung cancer that is composed of small ovoid cells. In the past, SCLC was called oat cell carcinoma because the microscopic appearance of the cells was felt to resemble oats. SLCLC usually originates near the bronchi and in many cases may grow and metastasize quickly. Evidence: PCS. (PMID:26168399)
- Autosomal dominant inheritance (HP:0000006): A mode of inheritance that is observed for traits related to a gene encoded on one of the autosomes (i.e., the human chromosomes 1-22) in which a trait manifests in heterozygotes. In the context of medical genetics, an autosomal dominant disorder is caused when a single copy of the mutant allele is present. Males and females are affected equally, and can both transmit the disorder with a risk of 50% for each child of inheriting the mutant allele. Evidence: TAS. (OMIM:182280)